Phenotypes associated with the disease FBLN1-related developmental delay-central nervous system anomaly-syndactyly syndrome (ORPHA:404451):
- Cryptorchidism (HP:0000028): Testis in inguinal canal. That is, absence of one or both testes from the scrotum owing to failure of the testis or testes to descend through the inguinal canal to the scrotum. Evidence: TAS. Frequency: Frequent (HP:0040282). (ORPHA:404451)
- Macular degeneration (HP:0000608): A nonspecific term denoting degeneration of the retinal pigment epithelium and/or retinal photoreceptor cells of the macula lutea. Evidence: TAS. Frequency: Frequent (HP:0040282). (ORPHA:404451)
- Delayed speech and language development (HP:0000750): A degree of language development that is significantly below the norm for a child of a specified age. Evidence: TAS. Frequency: Frequent (HP:0040282). (ORPHA:404451)
- Syndactyly (HP:0001159): Webbing or fusion of the fingers or toes, involving soft parts only or including bone structure. Bony fusions are referred to as "bony" syndactyly if the fusion occurs in a radio-ulnar axis. Fusions of bones of the fingers or toes in a proximo-distal axis are referred to as "symphalangism". Evidence: TAS. Frequency: Frequent (HP:0040282). (ORPHA:404451)
- Dysarthria (HP:0001260): Dysarthric speech is a general description referring to a neurological speech disorder characterized by poor articulation. Depending on the involved neurological structures, dysarthria may be further classified as spastic, flaccid, ataxic, hyperkinetic and hypokinetic, or mixed. Evidence: TAS. Frequency: Frequent (HP:0040282). (ORPHA:404451)
- Motor delay (HP:0001270): A type of Developmental delay characterized by a delay in acquiring motor skills. Evidence: TAS. Frequency: Frequent (HP:0040282). (ORPHA:404451)
- Spastic tetraparesis (HP:0001285): Spastic weakness affecting all four limbs. Evidence: TAS. Frequency: Frequent (HP:0040282). (ORPHA:404451)
- Dystonia (HP:0001332): An abnormally increased muscular tone that causes fixed abnormal postures. There is a slow, intermittent twisting motion that leads to exaggerated turning and posture of the extremities and trunk. Evidence: TAS. Frequency: Frequent (HP:0040282). (ORPHA:404451)
- Cerebral cortical atrophy (HP:0002120): Atrophy of the cortex of the cerebrum. Evidence: TAS. Frequency: Frequent (HP:0040282). (ORPHA:404451)
- Pseudobulbar signs (HP:0002200): Pseudobulbar signs result from injury to an upper motor neuron lesion to the corticobulbar pathways in the pyramidal tract. Patients have difficulty chewing, swallowing and demonstrate slurred speech (often initial presentation) as well as abnormal behavioral symptoms such as inappropriate emotional outbursts of uncontrolled laughter or weeping etc. Evidence: TAS. Frequency: Frequent (HP:0040282). (ORPHA:404451)
- Drooling (HP:0002307): Habitual flow of saliva out of the mouth. Evidence: TAS. Frequency: Frequent (HP:0040282). (ORPHA:404451)
- Moderate intellectual disability (HP:0002342): Moderate intellectual disability (ID) is defined as a type of ID characterized by moderately sub-average adaptive functioning and intellectual functioning, with an intelligence quotient (IQ) the range of 35-49. Evidence: TAS. Frequency: Frequent (HP:0040282). (ORPHA:404451)
- Syringomyelia (HP:0003396): Dilated, glial-lined cavity in spinal cord. This cavity does not communicate with the central canal, and usually is between the dorsal columns unilaterally or bilaterally along the side of the cord. Evidence: TAS. Frequency: Frequent (HP:0040282). (ORPHA:404451)
- Nonprogressive encephalopathy (HP:0007030). Evidence: TAS. Frequency: Frequent (HP:0040282). (ORPHA:404451)
- Congenital bilateral hip dislocation (HP:0008780). Evidence: TAS. Frequency: Frequent (HP:0040282). (ORPHA:404451)
- Choroidal neovascularization (HP:0011506): Choroidal neovascularization (CNV) is the inward growth of new blood vessels arising from the choriocapillaris. Depending on the stage of development, they can be external (type 1 NV) or internal (type 2 NV) to the retinal pigment epithelium. Evidence: TAS. Frequency: Frequent (HP:0040282). (ORPHA:404451)
- Infantile spasms (HP:0012469): Infantile spasms represent a subset of "epileptic spasms". Infantile Spasms are epileptic spasms starting in the first year of life (infancy). Evidence: TAS. Frequency: Frequent (HP:0040282). (ORPHA:404451)
- Delayed ability to walk (HP:0031936): A failure to achieve the ability to walk at an appropriate developmental stage. Most children learn to walk in a series of stages, and learn to walk short distances independently between 12 and 15 months. Evidence: TAS. Frequency: Frequent (HP:0040282). (ORPHA:404451)